- Congenital onset (HP:0003577): A phenotypic abnormality that is present at birth. Evidence: TAS. (OMIM:616481)
- Chronic rhinitis (HP:0002257): Chronic inflammation of the nasal mucosa. Evidence: PCS. Frequency: 5/5. (PMID:26073779)
- Situs inversus totalis (HP:0001696): A left-right reversal (or mirror reflection) of the anatomical location of the major thoracic and abdominal organs. Evidence: PCS. Frequency: 0/5. (PMID:26073779)
- Bronchiectasis (HP:0002110): Persistent abnormal dilatation of the bronchi owing to localized and irreversible destruction and widening of the large airways. Evidence: PCS. Frequency: 5/5. (PMID:26073779)
- Decreased nasal nitric oxide (HP:0033036): Reduced level of nasal nitric oxide (nNO). Current American Thoracic Society/European Respiratory Society (ATS/ERS) guidelines for nNO measurements recommend air aspiration via a nasal probe while the subject exhales through the mouth against resistance in order to maintain velum closure. Evidence: PCS. Frequency: 3/3. (PMID:26073779)
- Chronic sinusitis (HP:0011109): A chronic form of sinusitis. Evidence: PCS. Frequency: 5/5. (PMID:26073779)
- Ciliary dyskinesia (HP:0012265): A deviation from the normally well coordinated pattern of intracellular and intercellular synchrony of motile cilia. Dyskinetic cilia usually beat out of synchrony relative to neighboring cilia. Evidence: PCS. (PMID:26073779)
- Absent respiratory ciliary axoneme radial spokes (HP:0012267): Absence of the radial spokes of the axoneme of the respiratory cilium. Evidence: PCS. (PMID:26073779)
- Immotile cilia (HP:0012263). Evidence: PCS. (PMID:26073779)
- Infertility (HP:0000789). Evidence: PCS. Frequency: 2/5. (PMID:26073779)
- Autosomal recessive inheritance (HP:0000007): A mode of inheritance that is observed for traits related to a gene encoded on one of the autosomes (i.e., the human chromosomes 1-22) in which a trait manifests in individuals with two pathogenic alleles, either homozygotes (two copies of the same mutant allele) or compound heterozygotes (whereby each copy of a gene has a distinct mutant allele). Evidence: PCS. (PMID:26073779)
- Recurrent otitis media (HP:0000403): Increased susceptibility to otitis media, as manifested by recurrent episodes of otitis media. Evidence: PCS. Frequency: 5/5. (PMID:26073779)
- Chronic pulmonary obstruction (HP:0006510): An anomaly that is characterized progressive airflow obstruction that is only partly reversible, inflammation in the airways, and systemic effects or comorbities. Evidence: PCS. Frequency: 1/5. (PMID:26073779)
- Recurrent respiratory infections (HP:0002205): An increased susceptibility to respiratory infections as manifested by a history of recurrent respiratory infections. Evidence: TAS. (OMIM:616481)
- Neonatal respiratory distress (HP:0002643): Respiratory difficulty as newborn. Evidence: PCS. Frequency: 3/5. (PMID:26073779)
These phenotypes are associated with the disease primary ciliary dyskinesia 32 (OMIM:616481).